Phenotypes associated with the disease isolated microphthalmia 7 (OMIM:613704):
- Congenital onset (HP:0003577): A phenotypic abnormality that is present at birth. Evidence: PCS. (PMID:19864492)
- Microphthalmia (HP:0000568): A developmental anomaly characterized by abnormal smallness of one or both eyes. Evidence: PCS. Frequency: 2/3. (PMID:19864492)
- Autosomal dominant inheritance (HP:0000006): A mode of inheritance that is observed for traits related to a gene encoded on one of the autosomes (i.e., the human chromosomes 1-22) in which a trait manifests in heterozygotes. In the context of medical genetics, an autosomal dominant disorder is caused when a single copy of the mutant allele is present. Males and females are affected equally, and can both transmit the disorder with a risk of 50% for each child of inheriting the mutant allele. Evidence: PCS. (PMID:19864492)